- Malar flattening (HP:0000272): Underdevelopment of the malar prominence of the jugal bone (zygomatic bone in mammals), appreciated in profile, frontal view, and/or by palpation. Evidence: TAS. Frequency: Frequent (HP:0040282). (ORPHA:52056)
- Hemangioma (HP:0001028): A hemangioma is a benign tumor characterized by blood-filled spaces lined by benign endothelial cells. A hemangioma characterized by large endothelial spaces (caverns) is called a cavernous hemangioma (in contrast to a hemangioma with small endothelial spaces, which is called capillary hemangioma). Evidence: TAS. Frequency: Occasional (HP:0040283). (ORPHA:52056)
- Brachydactyly (HP:0001156): Digits that appear disproportionately short compared to the hand/foot. The word brachydactyly is used here to describe a series distinct patterns of shortened digits (brachydactyly types A-E). This is the sense used here. Evidence: TAS. Frequency: Frequent (HP:0040282). (ORPHA:52056)
- Growth delay (HP:0001510): A deficiency or slowing down of growth pre- and postnatally. Evidence: TAS. Frequency: Very frequent (HP:0040281). (ORPHA:52056)
- Atrial septal defect (HP:0001631): Atrial septal defect (ASD) is a congenital abnormality of the interatrial septum that enables blood flow between the left and right atria via the interatrial septum. Evidence: TAS. Frequency: Occasional (HP:0040283). (ORPHA:52056)
- Talipes equinovarus (HP:0001762): Talipes equinovarus (also called clubfoot) typically has four main components: inversion and adduction of the forefoot; inversion of the heel and hindfoot; equinus (limitation of extension) of the ankle and subtalar joint; and internal rotation of the leg. Evidence: TAS. Frequency: Occasional (HP:0040283). (ORPHA:52056)
- Short foot (HP:0001773): A measured foot length that is more than 2 SD below the mean for a newborn of 27 - 41 weeks gestation, or foot that is less than the 3rd centile for individuals from birth to 16 years of age (objective). Alternatively, a foot that appears disproportionately short (subjective). Evidence: TAS. Frequency: Occasional (HP:0040283). (ORPHA:52056)
- Short stature (HP:0004322): A height below that which is expected according to age and gender norms. Although there is no universally accepted definition of short stature, many refer to "short stature" as height more than 2 standard deviations below the mean for age and gender (or below the 3rd percentile for age and gender dependent norms). Evidence: TAS. Frequency: Frequent (HP:0040282). (ORPHA:52056)
- Postaxial oligodactyly (HP:0006210). Evidence: TAS. Frequency: Occasional (HP:0040283). (ORPHA:52056)
- Aplasia/Hypoplasia of the fibula (HP:0006492): Absence or underdevelopment of the fibula. Evidence: TAS. Frequency: Frequent (HP:0040282). (ORPHA:52056)
- Aplasia/Hypoplasia of the ulna (HP:0006495): Absence or underdevelopment of the ulna. Evidence: TAS. Frequency: Frequent (HP:0040282). (ORPHA:52056)
- Short 5th finger (HP:0009237): Hypoplasia (congenital reduction in size) of the fifth finger, also known as the little finger. Evidence: TAS. Frequency: Frequent (HP:0040282). (ORPHA:52056)
These phenotypes are associated with the disease Ulnar/fibula ray defect-brachydactyly syndrome (ORPHA:52056).